Phenotypes associated with the disease Cryptococcosis (ORPHA:1546):
- Fever (HP:0001945): Body temperature elevated above the normal range. Evidence: TAS. Frequency: Frequent (HP:0040282). (ORPHA:1546)
- Immunodeficiency (HP:0002721): Failure of the immune system to protect the body adequately from infection, due to the absence or insufficiency of some component process or substance. Evidence: TAS. Frequency: Frequent (HP:0040282). (ORPHA:1546)
- Cough (HP:0012735): A sudden, audible expulsion of air from the lungs through a partially closed glottis, preceded by inhalation. Evidence: TAS. Frequency: Frequent (HP:0040282). (ORPHA:1546)
- Nodular pattern on pulmonary HRCT (HP:0025392): A nodular pattern is characterized on pulmonary high-resolution computed tomography by the presence of numerous rounded opacities that range from 2 mm to 1 cm in diameter, with micronodules defined as smaller than 3 mm in diameter. Evidence: TAS. Frequency: Frequent (HP:0040282). (ORPHA:1546)
- Hydrocephalus (HP:0000238): Hydrocephalus is an active distension of the ventricular system of the brain resulting from inadequate passage of CSF from its point of production within the cerebral ventricles to its point of absorption into the systemic circulation. Evidence: TAS. Frequency: Occasional (HP:0040283). (ORPHA:1546)
- Abnormality of the eye (HP:0000478): Any abnormality of the eye, including location, spacing, and intraocular abnormalities. Evidence: TAS. Frequency: Occasional (HP:0040283). (ORPHA:1546)
- Abnormality of vision (HP:0000504): Abnormality of eyesight (visual perception). Evidence: TAS. Frequency: Occasional (HP:0040283). (ORPHA:1546)
- Atypical behavior (HP:0000708): Atypical behavior is an abnormality in a person's actions that can be controlled or modulated by the will of the individual. While abnormal behaviors can be difficult to control, they are distinct from other abnormal actions that cannot be affected by the individual's will. Evidence: TAS. Frequency: Occasional (HP:0040283). (ORPHA:1546)
- Mental deterioration (HP:0001268): Loss of previously present mental abilities, generally in adults. Evidence: TAS. Frequency: Occasional (HP:0040283). (ORPHA:1546)
- Meningitis (HP:0001287): Inflammation of the meninges. Evidence: TAS. Frequency: Occasional (HP:0040283). (ORPHA:1546)
- Cirrhosis (HP:0001394): A chronic disorder of the liver in which liver tissue becomes scarred and is partially replaced by regenerative nodules and fibrotic tissue resulting in loss of liver function. Evidence: TAS. Frequency: Occasional (HP:0040283). (ORPHA:1546)
- Vomiting (HP:0002013): Forceful ejection of the contents of the stomach through the mouth by means of a series of involuntary spasmic contractions. Evidence: TAS. Frequency: Occasional (HP:0040283). (ORPHA:1546)
- Pneumonia (HP:0002090): Inflammation of any part of the lung parenchyma. Evidence: TAS. Frequency: Occasional (HP:0040283). (ORPHA:1546)
- Dyspnea (HP:0002094): Difficult or labored breathing. Dyspnea is a subjective feeling only the patient can rate, e.g., on a Borg scale. Evidence: TAS. Frequency: Occasional (HP:0040283). (ORPHA:1546)
- Respiratory distress (HP:0002098): Respiratory distress is objectively observable as the physical or emotional consequences from the experience of dyspnea. The physical presentation of respiratory distress is generally referred to as labored breathing, while the sensation of respiratory distress is called shortness of breath or dyspnea. Evidence: TAS. Frequency: Occasional (HP:0040283). (ORPHA:1546)
- Cerebral cortical atrophy (HP:0002120): Atrophy of the cortex of the cerebrum. Evidence: TAS. Frequency: Occasional (HP:0040283). (ORPHA:1546)
- Pleural effusion (HP:0002202): The presence of an excessive amount of fluid in the pleural cavity. Evidence: TAS. Frequency: Occasional (HP:0040283). (ORPHA:1546)
- Headache (HP:0002315): Cephalgia, or pain sensed in various parts of the head, not confined to the area of distribution of any nerve. Evidence: TAS. Frequency: Occasional (HP:0040283). (ORPHA:1546)
- Increased intracranial pressure (HP:0002516): An increase of the pressure inside the cranium (skull) and thereby in the brain tissue and cerebrospinal fluid. Evidence: TAS. Frequency: Occasional (HP:0040283). (ORPHA:1546)
- Neoplasm (HP:0002664): An organ or organ-system abnormality that consists of uncontrolled autonomous cell-proliferation which can occur in any part of the body as a benign or malignant neoplasm (tumor). Evidence: TAS. Frequency: Occasional (HP:0040283). (ORPHA:1546)
- Systemic lupus erythematosus (HP:0002725): A chronic, relapsing, inflammatory, and often febrile multisystemic disorder of connective tissue, characterized principally by involvement of the skin, joints, kidneys, and serosal membranes. Evidence: TAS. Frequency: Occasional (HP:0040283). (ORPHA:1546)
- Autoimmunity (HP:0002960): The occurrence of an immune reaction against the organism's own cells or tissues. Evidence: TAS. Frequency: Occasional (HP:0040283). (ORPHA:1546)
- Limb muscle weakness (HP:0003690): Reduced strength and weakness of the muscles of the arms and legs. Evidence: TAS. Frequency: Occasional (HP:0040283). (ORPHA:1546)
- Nuchal rigidity (HP:0031179): Resistance of the extensor muscles of the neck to being bent forwards (i.e., impaired neck flexion) as a result of muscle spasm of the extensor muscles of the neck. Nuchal rigidity is not a fixed rigidity. Nuchal rigidity has been used as a bedside test for meningism, although its sensitivity for this purpose has been debated. Evidence: TAS. Frequency: Occasional (HP:0040283). (ORPHA:1546)
- Mediastinal lymphadenopathy (HP:0100721): Swelling of lymph nodes within the mediastinum, the central compartment of the thoracic cavities that contains the heart and the great vessels, the esophagus, and trachea and other structures including lymph nodes. Evidence: TAS. Frequency: Occasional (HP:0040283). (ORPHA:1546)
- Chest pain (HP:0100749): An unpleasant sensation characterized by physical discomfort (such as pricking, throbbing, or aching) localized to the chest. Evidence: TAS. Frequency: Occasional (HP:0040283). (ORPHA:1546)
- Prostatitis (HP:0000024): The presence of inflammation of the prostate. Evidence: TAS. Frequency: Very rare (HP:0040284). (ORPHA:1546)
- Abnormality of the outer ear (HP:0000356): An abnormality of the external ear. Evidence: TAS. Frequency: Very rare (HP:0040284). (ORPHA:1546)
- Abnormal retinal morphology (HP:0000479): A structural abnormality of the retina. Evidence: TAS. Frequency: Very rare (HP:0040284). (ORPHA:1546)
- Abnormal optic nerve morphology (HP:0000587): Abnormality of the optic nerve. Evidence: TAS. Frequency: Very rare (HP:0040284). (ORPHA:1546)
- Ophthalmoplegia (HP:0000602): Paralysis of one or more extraocular muscles that are responsible for eye movements. Evidence: TAS. Frequency: Very rare (HP:0040284). (ORPHA:1546)
- Blindness (HP:0000618): Blindness is the condition of lacking visual perception defined as a profound reduction in visual perception. On the 6m visual acuity scale, blindness is defined as less than 3/60. On the 20ft visual acuity scale, blindness is defined as less than 20/400. On the decimal visual acuity scale, blindness is defined as less than 0.05. Blindness is typically characterized by a visual field of no greater than 10 degrees in radius around central fixation. Evidence: TAS. Frequency: Very rare (HP:0040284). (ORPHA:1546)
- Seizure (HP:0001250): A seizure is an intermittent abnormality of nervous system physiology characterized by a transient occurrence of signs and/or symptoms due to abnormal excessive or synchronous neuronal activity in the brain. Evidence: TAS. Frequency: Very rare (HP:0040284). (ORPHA:1546)
- Abnormal cranial nerve morphology (HP:0001291): Structural abnormality affecting one or more of the cranial nerves, which emerge directly from the brain stem. Evidence: TAS. Frequency: Very rare (HP:0040284). (ORPHA:1546)
- Cerebral edema (HP:0002181): Abnormal accumulation of fluid in the brain. Evidence: TAS. Frequency: Very rare (HP:0040284). (ORPHA:1546)
- Memory impairment (HP:0002354): An impairment of memory as manifested by a reduced ability to remember things such as dates and names, and increased forgetfulness. Evidence: TAS. Frequency: Very rare (HP:0040284). (ORPHA:1546)
- Peritonitis (HP:0002586): Inflammation of the peritoneum. Evidence: TAS. Frequency: Very rare (HP:0040284). (ORPHA:1546)
- Osteomyelitis (HP:0002754): Osteomyelitis is an inflammatory process accompanied by bone destruction and caused by an infecting microorganism. Evidence: TAS. Frequency: Very rare (HP:0040284). (ORPHA:1546)
- Osteolysis (HP:0002797): Osteolysis refers to the destruction of bone through bone resorption with removal or loss of calcium. Evidence: TAS. Frequency: Very rare (HP:0040284). (ORPHA:1546)
- Lymphoid leukemia (HP:0005526): A malignant lymphocytic neoplasm of B-cell or T-cell lineage involving primarily the bone marrow and the peripheral blood. This category includes precursor or acute lymphoblastic leukemias and chronic leukemias. Evidence: TAS. Frequency: Very rare (HP:0040284). (ORPHA:1546)
- Vitritis (HP:0011531): Inflammation of the vitreous body, characterized by the presence of inflammatory cells and protein exudate in the vitreous cavity. Evidence: TAS. Frequency: Very rare (HP:0040284). (ORPHA:1546)
- Sepsis (HP:0100806): Sepsis is defined as life-threatening organ dysfunction caused by a dysregulated host response to infection. Evidence: TAS. Frequency: Very rare (HP:0040284). (ORPHA:1546)